- Delayed speech and language development (HP:0000750): A degree of language development that is significantly below the norm for a child of a specified age. Evidence: TAS. Frequency: Very frequent (HP:0040281). (ORPHA:254525)
- Hypotonia (HP:0001252): Hypotonia is an abnormally low muscle tone (the amount of tension or resistance to movement in a muscle). Even when relaxed, muscles have a continuous and passive partial contraction which provides some resistance to passive stretching. Hypotonia thus manifests as diminished resistance to passive stretching. Hypotonia is not the same as muscle weakness, although the two conditions can co-exist. Evidence: TAS. Frequency: Very frequent (HP:0040281). (ORPHA:254525)
- Motor delay (HP:0001270): A type of Developmental delay characterized by a delay in acquiring motor skills. Evidence: TAS. Frequency: Very frequent (HP:0040281). (ORPHA:254525)
- Short foot (HP:0001773): A measured foot length that is more than 2 SD below the mean for a newborn of 27 - 41 weeks gestation, or foot that is less than the 3rd centile for individuals from birth to 16 years of age (objective). Alternatively, a foot that appears disproportionately short (subjective). Evidence: TAS. Frequency: Very frequent (HP:0040281). (ORPHA:254525)
- Postnatal growth retardation (HP:0008897): Slow or limited growth after birth. Evidence: TAS. Frequency: Very frequent (HP:0040281). (ORPHA:254525)
- Small hand (HP:0200055): Disproportionately small hand. Evidence: TAS. Frequency: Very frequent (HP:0040281). (ORPHA:254525)
- Neonatal hypotonia (HP:0001319): Muscular hypotonia (abnormally low muscle tone) manifesting in the neonatal period. Evidence: TAS. Frequency: Frequent (HP:0040282). (ORPHA:254525)
- Intrauterine growth retardation (HP:0001511): An abnormal restriction of fetal growth with fetal weight below the tenth percentile for gestational age. Evidence: TAS. Frequency: Frequent (HP:0040282). (ORPHA:254525)
- Prominent forehead (HP:0011220): Forward prominence of the entire forehead, due to protrusion of the frontal bone. Evidence: TAS. Frequency: Frequent (HP:0040282). (ORPHA:254525)
- Abnormality of the genitourinary system (HP:0000119): The presence of any abnormality of the genitourinary system. Evidence: TAS. Frequency: Occasional (HP:0040283). (ORPHA:254525)
- Micrognathia (HP:0000347): Developmental hypoplasia of the mandible. Evidence: TAS. Frequency: Occasional (HP:0040283). (ORPHA:254525)
- Posteriorly rotated ears (HP:0000358): A type of abnormal location of the ears in which the position of the ears is characterized by posterior rotation (the superior part of the ears is rotated towards the back of the head, and the inferior part of the ears towards the front). Evidence: TAS. Frequency: Occasional (HP:0040283). (ORPHA:254525)
- Precocious puberty (HP:0000826): The onset of secondary sexual characteristics before a normal age. Although it is difficult to define normal age ranges because of the marked variation with which puberty begins in normal children, precocious puberty can be defined as the onset of puberty before the age of 8 years in girls or 9 years in boys. Evidence: TAS. Frequency: Occasional (HP:0040283). (ORPHA:254525)
- Intellectual disability (HP:0001249): The term intellectual disability or intellectual developmental disorder is used to describe significantly sub-average intellectual and adaptive functioning based on clinical assessment and as measured by individually administered, appropriately normed, standardized and validated tests of intellectual functioning and adaptive behavior, with onset during the developmental period from infancy through adolescence. Evidence: TAS. Frequency: Occasional (HP:0040283). (ORPHA:254525)
- Obesity (HP:0001513): Accumulation of substantial excess body fat. Evidence: TAS. Frequency: Occasional (HP:0040283). (ORPHA:254525)
- Abnormal heart morphology (HP:0001627): Any structural anomaly of the heart. Evidence: TAS. Frequency: Occasional (HP:0040283). (ORPHA:254525)
- Downturned corners of mouth (HP:0002714): A morphological abnormality of the mouth in which the angle of the mouth is downturned. The oral commissures are positioned inferior to the midline labial fissure. Evidence: TAS. Frequency: Occasional (HP:0040283). (ORPHA:254525)
- Relative macrocephaly (HP:0004482): A relatively mild degree of macrocephaly in which the head circumference is not above two standard deviations from the mean, but appears dysproportionately large when other factors such as body stature are taken into account. Evidence: TAS. Frequency: Occasional (HP:0040283). (ORPHA:254525)
- Poor fine motor coordination (HP:0007010): An abnormality of the ability (skills) to perform a precise movement of small muscles with the intent to perform a specific act. Fine motor skills are required to mediate movements of the wrists, hands, fingers, feet, and toes. Evidence: TAS. Frequency: Occasional (HP:0040283). (ORPHA:254525)
- Feeding difficulties in infancy (HP:0008872): Impaired feeding performance of an infant as manifested by difficulties such as weak and ineffective sucking, brief bursts of sucking, and falling asleep during sucking. There may be difficulties with chewing or maintaining attention. Evidence: TAS. Frequency: Occasional (HP:0040283). (ORPHA:254525)
- Clinodactyly (HP:0030084): An angulation of a digit at an interphalangeal joint in the plane of the palm (finger) or sole (toe). Evidence: TAS. Frequency: Occasional (HP:0040283). (ORPHA:254525)
- Acromicria (HP:0031878): Small hands and feet in proportion to the rest of the body. Evidence: TAS. Frequency: Occasional (HP:0040283). (ORPHA:254525)
These phenotypes are associated with the disease Temple syndrome due to paternal 14q32.2 microdeletion (ORPHA:254525).